Phenotypes associated with the disease spondyloarthropathy, susceptibility to, 1 (OMIM:106300):
- Inflammation of the large intestine (HP:0002037): Inflammation, or an inflammatory state in the large intestine. Evidence: TAS. (OMIM:106300)
- Sacroiliac arthritis (HP:0012317): Inflammation of the sacroiliac joint, generally accompanied by lower back pain. Evidence: TAS. (OMIM:106300)
- Arrhythmia (HP:0011675): Any cardiac rhythm other than the normal sinus rhythm. Such a rhythm may be either of sinus or ectopic origin and either regular or irregular. An arrhythmia may be due to a disturbance in impulse formation or conduction or both. Evidence: TAS. (OMIM:106300)
- Anterior uveitis (HP:0012122): Inflammation of the uveal tract in which the primary site of inflammation is the anterior chamber. Evidence: TAS. (OMIM:106300)
- Enthesitis (HP:0100686). Evidence: TAS. (OMIM:106300)
- Oligoarthritis (HP:0040313): A type of arthritis that affects up to four joints in the first six months of disease. Evidence: TAS. (OMIM:106300)
- Kyphosis (HP:0002808): Exaggerated anterior convexity of the thoracic vertebral column. Evidence: TAS. (OMIM:106300)
- Non-Mendelian inheritance (HP:0001426): A mode of inheritance that depends on genetic determinants in more than one gene. Evidence: TAS. (OMIM:106300)
- Aortic regurgitation (HP:0001659): An insufficiency of the aortic valve, leading to regurgitation (backward flow) of blood from the aorta into the left ventricle. Evidence: TAS. (OMIM:106300)
- Back pain (HP:0003418): An unpleasant sensation characterized by physical discomfort (such as pricking, throbbing, or aching) localized to the back. Evidence: TAS. (OMIM:106300)
- Rheumatoid factor positive (HP:0002923): The presence in the serum of an autoantibody directed against the Fc portion of IgG. Evidence: PCS. Frequency: 0/7. (PMID:7702399)
- Hip osteoarthritis (HP:0008843). Evidence: TAS. (OMIM:106300)
- Psoriasiform dermatitis (HP:0003765): A skin abnormality characterized by redness and irritation, with thick, red skin that displays flaky, silver-white patches (scales). Evidence: TAS. (OMIM:106300)